Phenotypes associated with the disease hyperthyroxinemia, dystransthyretinemic (OMIM:145680):
- Euthyroid hyperthyroxinemia (HP:0008247): Increased levels of thyroxine without evidence of clinical thyroid disease. Evidence: IEA. (OMIM:145680)
- Autosomal dominant inheritance (HP:0000006): A mode of inheritance that is observed for traits related to a gene encoded on one of the autosomes (i.e., the human chromosomes 1-22) in which a trait manifests in heterozygotes. In the context of medical genetics, an autosomal dominant disorder is caused when a single copy of the mutant allele is present. Males and females are affected equally, and can both transmit the disorder with a risk of 50% for each child of inheriting the mutant allele. Evidence: IEA. (OMIM:145680)